- Facial palsy (HP:0010628): Facial nerve palsy is a dysfunction of cranial nerve VII (the facial nerve) that results in inability to control facial muscles on the affected side with weakness of the muscles of facial expression and eye closure. This can either be present in unilateral or bilateral form. Evidence: IEA. (OMIM:134200)
- Autosomal dominant inheritance (HP:0000006): A mode of inheritance that is observed for traits related to a gene encoded on one of the autosomes (i.e., the human chromosomes 1-22) in which a trait manifests in heterozygotes. In the context of medical genetics, an autosomal dominant disorder is caused when a single copy of the mutant allele is present. Males and females are affected equally, and can both transmit the disorder with a risk of 50% for each child of inheriting the mutant allele. Evidence: IEA. (OMIM:134200)
These phenotypes are associated with the disease familial recurrent peripheral facial palsy (OMIM:134200).